Phenotypes associated with the disease Unstable beta globin chain variant disease (ORPHA:231226):
- Persistence of hemoglobin F (HP:0011904): Hemoglobin F (HbF) contains two globin alpha chains and two globin gamma chains. It is the main form of hemoglobin in the fetus during the last seven months of intrauterine development and in the half year of postnatal life. In adults it normally makes up less than one percent of all hemoglobin. This term refers to an increase in HbF above this limit. In beta thalassemia major, it may represent over 90 percent of all hemoglobin, and in beta thalassemia minor it may make up between 0.5 to 4 percent. Evidence: TAS. Frequency: Very frequent (HP:0040281). (ORPHA:231226)
- Reduced hemoglobin A (HP:0011905): Hemoglobin A (HbA) contains two globin alpha chains and two globin beta chains. HbA is normally the main adult hemoglobin, representing about 96-98 percent of all hemoglobin. This term represents a decreased in the proportion of HbA below this limit, and can be seen in various forms of thalassemia. Evidence: TAS. Frequency: Very frequent (HP:0040281). (ORPHA:231226)
- Pallor (HP:0000980): Abnormally pale skin. Evidence: TAS. Frequency: Frequent (HP:0040282). (ORPHA:231226)
- Hypersplenism (HP:0001971): A malfunctioning of the spleen in which it prematurely destroys red blood cells. Evidence: TAS. Frequency: Frequent (HP:0040282). (ORPHA:231226)
- Extramedullary hematopoiesis (HP:0001978): The process of hematopoiesis occurring outside of the bone marrow (in the liver, thymus, and spleen) in the postnatal organisms. Evidence: TAS. Frequency: Frequent (HP:0040282). (ORPHA:231226)
- Hypochromic microcytic anemia (HP:0004840): A type of anemia characterized by an abnormally low concentration of hemoglobin in the erythrocytes and lower than normal size of the erythrocytes. Evidence: TAS. Frequency: Frequent (HP:0040282). (ORPHA:231226)
- Anisocytosis (HP:0011273): Abnormally increased variability in the size of erythrocytes. Evidence: TAS. Frequency: Frequent (HP:0040282). (ORPHA:231226)
- Decreased mean corpuscular volume (HP:0025066): A reduction from normal of the mean corpuscular volume, or mean cell volume (MCV) of red blood cells (usually defined as an MCV below 80 femtoliters). Evidence: TAS. Frequency: Frequent (HP:0040282). (ORPHA:231226)
- Decreased mean corpuscular hemoglobin concentration (HP:0025547): A reduction from the normal range of the average amount of hemoglobin per red blood cell (27 to 31 picograms/cell). A reduced mean corpuscular hemoglobin (MCH) may indicate a hypochromic anemia, but the MCH may be normal if both the total hemoglobin and the red blood cell count are reduced. Evidence: TAS. Frequency: Frequent (HP:0040282). (ORPHA:231226)
- Abnormality of the dentition (HP:0000164): Any abnormality of the teeth. Evidence: TAS. Frequency: Occasional (HP:0040283). (ORPHA:231226)
- Irritability (HP:0000737): An emotional state characterized by negative feelings of heightened frustration, annoyance, or feeling upset, often triggered by internal factors (e.g., fatigue, hunger, unfulfilled desires) or external factors (e.g., social or environmental challenges). Irritability may be unpredictable, and is accompanied by a lowered threshold for emotional reactivity and observable features (speech, facial expressions, or psychomotor activity). Evidence: TAS. Frequency: Occasional (HP:0040283). (ORPHA:231226)
- Diabetes mellitus (HP:0000819): A group of abnormalities characterized by hyperglycemia and glucose intolerance. Evidence: TAS. Frequency: Occasional (HP:0040283). (ORPHA:231226)
- Hypothyroidism (HP:0000821): Deficiency of thyroid hormone. Evidence: TAS. Frequency: Occasional (HP:0040283). (ORPHA:231226)
- Delayed puberty (HP:0000823): Passing the age when puberty normally occurs with no physical or hormonal signs of the onset of puberty. Evidence: TAS. Frequency: Occasional (HP:0040283). (ORPHA:231226)
- Hypoparathyroidism (HP:0000829): A condition caused by a deficiency of parathyroid hormone characterized by hypocalcemia and hyperphosphatemia. Evidence: TAS. Frequency: Occasional (HP:0040283). (ORPHA:231226)
- Osteoporosis (HP:0000939): Osteoporosis is a systemic skeletal disease characterized by low bone density and microarchitectural deterioration of bone tissue with a consequent increase in bone fragility. According to the WHO criteria, osteoporosis is defined as a BMD that lies 2.5 standard deviations or more below the average value for young healthy adults (a T-score below -2.5 SD). Evidence: TAS. Frequency: Occasional (HP:0040283). (ORPHA:231226)
- Jaundice (HP:0000952): Yellow pigmentation of the skin due to bilirubin, which in turn is the result of increased bilirubin concentration in the bloodstream. Evidence: TAS. Frequency: Occasional (HP:0040283). (ORPHA:231226)
- Hyperpigmentation of the skin (HP:0000953): A darkening of the skin related to an increase in melanin production and deposition. Evidence: TAS. Frequency: Occasional (HP:0040283). (ORPHA:231226)
- Cirrhosis (HP:0001394): A chronic disorder of the liver in which liver tissue becomes scarred and is partially replaced by regenerative nodules and fibrotic tissue resulting in loss of liver function. Evidence: TAS. Frequency: Occasional (HP:0040283). (ORPHA:231226)
- Hepatic fibrosis (HP:0001395): The presence of excessive fibrous connective tissue in the liver. Fibrosis is a reparative or reactive process. Evidence: TAS. Frequency: Occasional (HP:0040283). (ORPHA:231226)
- Hepatosplenomegaly (HP:0001433): Simultaneous enlargement of the liver and spleen. Evidence: TAS. Frequency: Occasional (HP:0040283). (ORPHA:231226)
- Growth delay (HP:0001510): A deficiency or slowing down of growth pre- and postnatally. Evidence: TAS. Frequency: Occasional (HP:0040283). (ORPHA:231226)
- Failure to thrive in infancy (HP:0001531). Evidence: TAS. Frequency: Occasional (HP:0040283). (ORPHA:231226)
- Splenomegaly (HP:0001744): Abnormal increased size of the spleen. Evidence: TAS. Frequency: Occasional (HP:0040283). (ORPHA:231226)
- Recurrent fever (HP:0001954): Periodic (episodic or recurrent) bouts of fever. Evidence: TAS. Frequency: Occasional (HP:0040283). (ORPHA:231226)
- Diarrhea (HP:0002014): Abnormally increased frequency (usually defined as three or more) loose or watery bowel movements a day. Evidence: TAS. Frequency: Occasional (HP:0040283). (ORPHA:231226)
- Dyspnea (HP:0002094): Difficult or labored breathing. Dyspnea is a subjective feeling only the patient can rate, e.g., on a Borg scale. Evidence: TAS. Frequency: Occasional (HP:0040283). (ORPHA:231226)
- Arthralgia (HP:0002829): Joint pain. Evidence: TAS. Frequency: Occasional (HP:0040283). (ORPHA:231226)
- Genu valgum (HP:0002857): The legs angle inward, such that the knees are close together and the ankles far apart. Evidence: TAS. Frequency: Occasional (HP:0040283). (ORPHA:231226)
- Venous thrombosis (HP:0004936): Formation of a blood clot (thrombus) inside a vein, causing the obstruction of blood flow. Evidence: TAS. Frequency: Occasional (HP:0040283). (ORPHA:231226)
- Bowing of the long bones (HP:0006487): A bending or abnormal curvature of a long bone. Evidence: TAS. Frequency: Occasional (HP:0040283). (ORPHA:231226)
- Hypoplasia of the musculature (HP:0009004): Underdevelopment of the musculature. Evidence: TAS. Frequency: Occasional (HP:0040283). (ORPHA:231226)
- Abnormality of iron homeostasis (HP:0011031): An abnormality of the homeostasis (concentration) of iron cation. Evidence: TAS. Frequency: Occasional (HP:0040283). (ORPHA:231226)
- Abnormal skeletal morphology (HP:0011842): An abnormality of the form, structure, or size of the skeletal system. Evidence: TAS. Frequency: Occasional (HP:0040283). (ORPHA:231226)
- Feeding difficulties (HP:0011968): Impaired ability to eat related to problems gathering food and getting ready to suck, chew, or swallow it. Evidence: TAS. Frequency: Occasional (HP:0040283). (ORPHA:231226)
- Chronic infection (HP:0031035): Presence of a protracted or persistent infection by a pathogen potentially related to an underlying abnormality of the immune system that is not able to clear the infection. Evidence: TAS. Frequency: Occasional (HP:0040283). (ORPHA:231226)
- Hypopituitarism (HP:0040075). Evidence: TAS. Frequency: Occasional (HP:0040283). (ORPHA:231226)
- Skin ulcer (HP:0200042): A discontinuity of the skin exhibiting complete loss of the epidermis and often portions of the dermis and even subcutaneous fat. Evidence: TAS. Frequency: Occasional (HP:0040283). (ORPHA:231226)
- Chronic hepatitis (HP:0200123): Hepatitis that lasts for more than six months. Evidence: TAS. Frequency: Occasional (HP:0040283). (ORPHA:231226)
- Upslanted palpebral fissure (HP:0000582): The palpebral fissure inclination is more than two standard deviations above the mean for age (objective); or, the inclination of the palpebral fissure is greater than typical for age. Evidence: TAS. Frequency: Very rare (HP:0040284). (ORPHA:231226)
- Adrenal insufficiency (HP:0000846): Insufficient production of steroid hormones (primarily cortisol) by the adrenal glands. Evidence: TAS. Frequency: Very rare (HP:0040284). (ORPHA:231226)
- Hepatocellular carcinoma (HP:0001402): A kind of neoplasm of the liver that originates in hepatocytes and presents macroscopically as a soft and hemorrhagic tan mass in the liver. Evidence: TAS. Frequency: Very rare (HP:0040284). (ORPHA:231226)
- Dilated cardiomyopathy (HP:0001644): Dilated cardiomyopathy (DCM) is defined by the presence of left ventricular dilatation and left ventricular systolic dysfunction in the absence of abnormal loading conditions (hypertension, valve disease) or coronary artery disease sufficient to cause global systolic impairment. Right ventricular dilation and dysfunction may be present but are not necessary for the diagnosis. Evidence: TAS. Frequency: Very rare (HP:0040284). (ORPHA:231226)
- High-output congestive heart failure (HP:0001722): A form of heart failure characterized by elevated cardiac output. This may be seen in patients with heart failure and hyperthyroidism, anemia, pregnancy, arteriovenous fistulae, and others. Evidence: TAS. Frequency: Very rare (HP:0040284). (ORPHA:231226)
- Frontal bossing (HP:0002007): Bilateral bulging of the lateral frontal bone prominences with relative sparing of the midline. Evidence: TAS. Frequency: Very rare (HP:0040284). (ORPHA:231226)
- Depressed nasal bridge (HP:0005280): Posterior positioning of the nasal root in relation to the overall facial profile for age. Evidence: TAS. Frequency: Very rare (HP:0040284). (ORPHA:231226)
- Malar prominence (HP:0010620): Prominence of the malar process of the maxilla and infraorbital area appreciated in profile and from in front of the face. Evidence: TAS. Frequency: Very rare (HP:0040284). (ORPHA:231226)
- Arrhythmia (HP:0011675): Any cardiac rhythm other than the normal sinus rhythm. Such a rhythm may be either of sinus or ectopic origin and either regular or irregular. An arrhythmia may be due to a disturbance in impulse formation or conduction or both. Evidence: TAS. Frequency: Very rare (HP:0040284). (ORPHA:231226)
- Hyperplasia of the maxilla (HP:0430028): Abnormally increased dimension of the maxilla, especially relative to the mandible, resulting in a malocclusion or malalignment between the upper and lower teeth or in anterior positioning of the nasal base, increased convexity of the face, increased nasolabial angle, or increased width (transverse dimension of the maxilla. Evidence: TAS. Frequency: Very rare (HP:0040284). (ORPHA:231226)